- Decreased fertility (HP:0000144). Evidence: IEA. (OMIM:158250)
- Abnormality of chromosome segregation (HP:0002916): An abnormality of chromosome segregation. Evidence: IEA. (OMIM:158250)
- Autosomal recessive inheritance (HP:0000007): A mode of inheritance that is observed for traits related to a gene encoded on one of the autosomes (i.e., the human chromosomes 1-22) in which a trait manifests in individuals with two pathogenic alleles, either homozygotes (two copies of the same mutant allele) or compound heterozygotes (whereby each copy of a gene has a distinct mutant allele). Evidence: IEA. (OMIM:158250)
- Autosomal dominant inheritance (HP:0000006): A mode of inheritance that is observed for traits related to a gene encoded on one of the autosomes (i.e., the human chromosomes 1-22) in which a trait manifests in heterozygotes. In the context of medical genetics, an autosomal dominant disorder is caused when a single copy of the mutant allele is present. Males and females are affected equally, and can both transmit the disorder with a risk of 50% for each child of inheriting the mutant allele. Evidence: IEA. (OMIM:158250)
These phenotypes are associated with the disease nondisjunction (OMIM:158250).